- Hydrometrocolpos (HP:0030010): Hydrometrocolpos is an accumulation of uterine and vaginal secretions as well as menstrual blood in the uterus and vagina. Evidence: TAS. Frequency: Very frequent (HP:0040281). (ORPHA:2473)
- Cryptorchidism (HP:0000028): Testis in inguinal canal. That is, absence of one or both testes from the scrotum owing to failure of the testis or testes to descend through the inguinal canal to the scrotum. Evidence: TAS. Frequency: Frequent (HP:0040282). (ORPHA:2473)
- Hydronephrosis (HP:0000126): Severe distention of the kidney with dilation of the renal pelvis and calices. Evidence: TAS. Frequency: Frequent (HP:0040282). (ORPHA:2473)
- Glanular hypospadias (HP:0000807): A type of hypospadias in which the urethral meatus is located at the head of the penis, but not all the way at the tip. Evidence: TAS. Frequency: Frequent (HP:0040282). (ORPHA:2473)
- Postaxial hand polydactyly (HP:0001162): Supernumerary digits located at the ulnar side of the hand (that is, on the side with the fifth finger). Evidence: TAS. Frequency: Frequent (HP:0040282). (ORPHA:2473)
- Urogenital sinus anomaly (HP:0100779): A rare birth defect in women where the urethra and vagina both open into a common channel. Evidence: TAS. Frequency: Frequent (HP:0040282). (ORPHA:2473)
- Multicystic kidney dysplasia (HP:0000003): Multicystic dysplasia of the kidney is characterized by multiple cysts of varying size in the kidney and the absence of a normal pelvicaliceal system. The condition is associated with ureteral or ureteropelvic atresia, and the affected kidney is nonfunctional. Evidence: TAS. Frequency: Occasional (HP:0040283). (ORPHA:2473)
- Cleft palate (HP:0000175): Cleft palate is a developmental defect of the palate resulting from a failure of fusion of the palatine processes and manifesting as a separation of the roof of the mouth (soft and hard palate). Evidence: TAS. Frequency: Occasional (HP:0040283). (ORPHA:2473)
- High palate (HP:0000218): Height of the palate more than 2 SD above the mean (objective) or palatal height at the level of the first permanent molar more than twice the height of the teeth (subjective). Evidence: TAS. Frequency: Occasional (HP:0040283). (ORPHA:2473)
- Brachydactyly (HP:0001156): Digits that appear disproportionately short compared to the hand/foot. The word brachydactyly is used here to describe a series distinct patterns of shortened digits (brachydactyly types A-E). This is the sense used here. Evidence: TAS. Frequency: Occasional (HP:0040283). (ORPHA:2473)
- Intellectual disability (HP:0001249): The term intellectual disability or intellectual developmental disorder is used to describe significantly sub-average intellectual and adaptive functioning based on clinical assessment and as measured by individually administered, appropriately normed, standardized and validated tests of intellectual functioning and adaptive behavior, with onset during the developmental period from infancy through adolescence. Evidence: TAS. Frequency: Occasional (HP:0040283). (ORPHA:2473)
- Global developmental delay (HP:0001263): A delay in the achievement of motor or mental milestones in the domains of development of a child, including motor skills, speech and language, cognitive skills, and social and emotional skills. This term should only be used to describe children younger than five years of age. Evidence: TAS. Frequency: Occasional (HP:0040283). (ORPHA:2473)
- Failure to thrive (HP:0001508): Failure to thrive (FTT) refers to a child whose physical growth is substantially below the norm. Evidence: TAS. Frequency: Occasional (HP:0040283). (ORPHA:2473)
- Ventricular septal defect (HP:0001629): A hole between the two bottom chambers (ventricles) of the heart. The defect is centered around the most superior aspect of the ventricular septum. Evidence: TAS. Frequency: Occasional (HP:0040283). (ORPHA:2473)
- Atrial septal defect (HP:0001631): Atrial septal defect (ASD) is a congenital abnormality of the interatrial septum that enables blood flow between the left and right atria via the interatrial septum. Evidence: TAS. Frequency: Occasional (HP:0040283). (ORPHA:2473)
- Tetralogy of Fallot (HP:0001636): A congenital cardiac malformation comprising pulmonary stenosis, overriding aorta, ventricular septum defect, and right ventricular hypertrophy. The diagnosis of TOF is made if at least three of the four above mentioned features are present. Evidence: TAS. Frequency: Occasional (HP:0040283). (ORPHA:2473)
- Patent ductus arteriosus (HP:0001643): In utero, the ductus arteriosus (DA) serves to divert ventricular output away from the lungs and toward the placenta by connecting the main pulmonary artery to the descending aorta. A patent ductus arteriosus (PDA) in the first 3 days of life is a physiologic shunt in healthy term and preterm newborn infants, and normally is substantially closed within about 24 hours after bith and completely closed after about three weeks. Failure of physiologcal closure is referred to a persistent or patent ductus arteriosus (PDA). Depending on the degree of left-to-right shunting, PDA can have clinical consequences. Evidence: TAS. Frequency: Occasional (HP:0040283). (ORPHA:2473)
- Postaxial foot polydactyly (HP:0001830): Polydactyly of the foot most commonly refers to the presence of six toes on one foot. Postaxial polydactyly affects the lateral ray and the duplication may range from a well-formed articulated digit to a rudimentary digit. Evidence: TAS. Frequency: Occasional (HP:0040283). (ORPHA:2473)
- Anal atresia (HP:0002023): Congenital absence of the anus, i.e., the opening at the bottom end of the intestinal tract. Evidence: TAS. Frequency: Occasional (HP:0040283). (ORPHA:2473)
- Aganglionic megacolon (HP:0002251): An abnormality resulting from a lack of intestinal ganglion cells (i.e., an aganglionic section of bowel) that results in bowel obstruction with enlargement of the colon. Evidence: TAS. Frequency: Occasional (HP:0040283). (ORPHA:2473)
- Short stature (HP:0004322): A height below that which is expected according to age and gender norms. Although there is no universally accepted definition of short stature, many refer to "short stature" as height more than 2 standard deviations below the mean for age and gender (or below the 3rd percentile for age and gender dependent norms). Evidence: TAS. Frequency: Occasional (HP:0040283). (ORPHA:2473)
- Hypoplastic left ventricle (HP:0004383): A severe congenital heart defect characterized by underdevelopment of the left ventricle. Evidence: TAS. Frequency: Occasional (HP:0040283). (ORPHA:2473)
- Ectopic anus (HP:0004397): Abnormal displacement or malposition of the anus. Evidence: TAS. Frequency: Occasional (HP:0040283). (ORPHA:2473)
- Abnormal metacarpal morphology (HP:0005916): Any abnormal shape or structure of the metacarpal bones. Evidence: TAS. Frequency: Occasional (HP:0040283). (ORPHA:2473)
- Finger syndactyly (HP:0006101): Webbing or fusion of the fingers, involving soft parts only or including bone structure. Bony fusions are referred to as "bony" Syndactyly if the fusion occurs in a radio-ulnar axis. Fusions of bones of the fingers in a proximo-distal axis are referred to as "Symphalangism". Evidence: TAS. Frequency: Occasional (HP:0040283). (ORPHA:2473)
- Tarsal synostosis (HP:0008368): Synostosis (bony fusion) involving one or more bones of the tarsus (calcaneus, talus, cuboid, navicular, cuneiiform bones). Evidence: TAS. Frequency: Occasional (HP:0040283). (ORPHA:2473)
- Urethral stricture (HP:0012227): Narrowing of the urethra associated with inflammation or scar tissue. Evidence: TAS. Frequency: Occasional (HP:0040283). (ORPHA:2473)
- Renal hypoplasia/aplasia (HP:0008678): Absence or underdevelopment of the kidney. Evidence: TAS. Frequency: Very rare (HP:0040284). (ORPHA:2473)
These phenotypes are associated with the disease McKusick-Kaufman syndrome (ORPHA:2473).